Phenotypes associated with the disease acute myeloid leukemia (OMIM:601626):
- Typified by somatic mosaicism (HP:0001442): Description of conditions in which affected individuals typically display somatic mosaicism, i.e., genetically distinct populations of somatic cells in a given organism caused by DNA mutations, epigenetic alterations of DNA, chromosomal abnormalities or the spontaneous reversion of inherited mutations. In many conditions typified by somatic mosaicism, constitutive mutation is lethal and cases are exclusively or predominantly mosaic. Evidence: TAS. (OMIM:601626)
- Acute myeloid leukemia (HP:0004808): A form of leukemia characterized by overproduction of an early myeloid cell. Evidence: TAS. (OMIM:601626)
- Autosomal dominant inheritance (HP:0000006): A mode of inheritance that is observed for traits related to a gene encoded on one of the autosomes (i.e., the human chromosomes 1-22) in which a trait manifests in heterozygotes. In the context of medical genetics, an autosomal dominant disorder is caused when a single copy of the mutant allele is present. Males and females are affected equally, and can both transmit the disorder with a risk of 50% for each child of inheriting the mutant allele. Evidence: TAS. (OMIM:601626)